Phenotypes associated with the disease butyrylcholinesterase deficiency (OMIM:617936):
- Autosomal recessive inheritance (HP:0000007): A mode of inheritance that is observed for traits related to a gene encoded on one of the autosomes (i.e., the human chromosomes 1-22) in which a trait manifests in individuals with two pathogenic alleles, either homozygotes (two copies of the same mutant allele) or compound heterozygotes (whereby each copy of a gene has a distinct mutant allele). Evidence: PCS. (PMID:21637541)
- Apnea (HP:0002104): Lack of breathing with no movement of the respiratory muscles and no exchange of air in the lungs. This term refers to a disposition to have recurrent episodes of apnea rather than to a single event. Evidence: PCS. (PMID:21637541)